Phenotypes associated with the disease fibromatosis, gingival, 1 (OMIM:135300):
- Hearing impairment (HP:0000365): A decreased magnitude of the sensory perception of sound. Evidence: PCS. Frequency: 0/38. (PMID:11868160)
- Gingival fibromatosis (HP:0000169): The presence of fibrosis of the gingiva. Evidence: PCS. Frequency: 38/38. (PMID:11868160)
- Autosomal dominant inheritance (HP:0000006): A mode of inheritance that is observed for traits related to a gene encoded on one of the autosomes (i.e., the human chromosomes 1-22) in which a trait manifests in heterozygotes. In the context of medical genetics, an autosomal dominant disorder is caused when a single copy of the mutant allele is present. Males and females are affected equally, and can both transmit the disorder with a risk of 50% for each child of inheriting the mutant allele. Evidence: PCS. (PMID:11868160)
- Intellectual disability (HP:0001249): The term intellectual disability or intellectual developmental disorder is used to describe significantly sub-average intellectual and adaptive functioning based on clinical assessment and as measured by individually administered, appropriately normed, standardized and validated tests of intellectual functioning and adaptive behavior, with onset during the developmental period from infancy through adolescence. Evidence: PCS. Frequency: 0/38. (PMID:11868160)